Phenotypes associated with the disease tremor, hereditary essential, 2 (OMIM:602134):
- Upper limb postural tremor (HP:0007351): A type of tremors that is triggered by holding an arm in a fixed position. Evidence: IEA. (OMIM:602134)
- Kinetic tremor (HP:0030186): Tremor that occurs during any voluntary movement. It may include visually or non-visually guided movements. Tremor during target directed movement is called intention tremor. Evidence: TAS. (OMIM:602134)
- Fatigue (HP:0012378): A subjective feeling of tiredness characterized by a lack of energy and motivation. Evidence: IEA. (OMIM:602134)
- Autosomal dominant inheritance (HP:0000006): A mode of inheritance that is observed for traits related to a gene encoded on one of the autosomes (i.e., the human chromosomes 1-22) in which a trait manifests in heterozygotes. In the context of medical genetics, an autosomal dominant disorder is caused when a single copy of the mutant allele is present. Males and females are affected equally, and can both transmit the disorder with a risk of 50% for each child of inheriting the mutant allele. Evidence: IEA. (OMIM:602134)